Phenotypes associated with the disease mitochondrial complex I deficiency, nuclear type 37 (OMIM:619272):
- Hypertonia (HP:0001276): A condition in which there is increased muscle tone so that arms or legs, for example, are stiff and difficult to move. Evidence: PCS. Frequency: 2/3. (PMID:32385911;PMID:33153867)
- Poor head control (HP:0002421): Difficulty to maintain correct position of the head while standing or sitting. Infant head lag is observed when the head seems to flop around or lags posteriorly behind the trunk. Several articles have maintained that head lag should be absent by age 3 to 4 months. Evidence: PCS. Frequency: 1/1. (PMID:32385911)
- Inguinal hernia (HP:0000023): Protrusion of the contents of the abdominal cavity through the inguinal canal. Evidence: PCS. Frequency: 1/1. (PMID:32385911)
- Cerebellar atrophy (HP:0001272): Cerebellar atrophy is defined as a cerebellum with initially normal structures, in a posterior fossa with normal size, which displays enlarged fissures (interfolial spaces) in comparison to the foliae secondary to loss of tissue. Cerebellar atrophy implies irreversible loss of tissue and result from an ongoing progressive disease until a final stage is reached or a single injury, e.g. an intoxication or infectious event. Evidence: PCS. Frequency: 1/1. Onset: Young adult onset (HP:0011462). (PMID:32385911)
- Seizure (HP:0001250): A seizure is an intermittent abnormality of nervous system physiology characterized by a transient occurrence of signs and/or symptoms due to abnormal excessive or synchronous neuronal activity in the brain. Evidence: PCS. Frequency: 2/3. (PMID:32385911;PMID:33153867)
- Cerebral cortical atrophy (HP:0002120): Atrophy of the cortex of the cerebrum. Evidence: PCS. Frequency: 1/2. (PMID:33153867)
- Hypotonia (HP:0001252): Hypotonia is an abnormally low muscle tone (the amount of tension or resistance to movement in a muscle). Even when relaxed, muscles have a continuous and passive partial contraction which provides some resistance to passive stretching. Hypotonia thus manifests as diminished resistance to passive stretching. Hypotonia is not the same as muscle weakness, although the two conditions can co-exist. Evidence: PCS. Frequency: 1/2. (PMID:33153867)
- Infantile onset (HP:0003593): Onset of signs or symptoms of disease between 28 days to one year of life. Evidence: PCS. Frequency: 1/1. (PMID:32385911)
- Motor delay (HP:0001270): A type of Developmental delay characterized by a delay in acquiring motor skills. Evidence: PCS. Frequency: 1/2. (PMID:33153867)
- Failure to thrive (HP:0001508): Failure to thrive (FTT) refers to a child whose physical growth is substantially below the norm. Evidence: PCS. Frequency: 3/3. (PMID:32385911;PMID:33153867)
- Ventriculomegaly (HP:0002119): An increase in size of the ventricular system of the brain. Evidence: PCS. Frequency: 1/1. (PMID:32385911)
- High palate (HP:0000218): Height of the palate more than 2 SD above the mean (objective) or palatal height at the level of the first permanent molar more than twice the height of the teeth (subjective). Evidence: PCS. Frequency: 1/1. (PMID:32385911)
- Lactic acidosis (HP:0003128): An abnormal buildup of lactic acid in the body, leading to acidification of the blood and other bodily fluids. Evidence: PCS. Frequency: 1/2. (PMID:33153867)
- Opisthotonus (HP:0002179): Opisthotonus is defined as a dramatic abnormal posture due to spastic contraction of the extensor muscles of the neck, trunk, and lower extremities that produces a severe backward arching from neck to heel. In most cases, the trunk is elevated off the ground by a few inches. It is usually sudden in onset and can be sustained or repetitive. It can be considered a variant of decerebrate posturing involving a hyperextension of the neck, back, and limbs. Evidence: PCS. Frequency: 1/1. Onset: Infantile onset (HP:0003593). (PMID:32385911)
- Delayed ability to roll over (HP:0032989): Delayed achievement of the ability to roll front to back and back to front. Evidence: PCS. Frequency: 1/1. (PMID:32385911)
- Skeletal muscle atrophy (HP:0003202): The presence of skeletal muscular atrophy (which is also known as amyotrophy). Evidence: PCS. Frequency: 1/2. (PMID:33153867)
- Cerebral atrophy (HP:0002059): Atrophy (wasting, decrease in size of cells or tissue) affecting the cerebrum. Evidence: PCS. Frequency: 1/1. (PMID:32385911)
- Microcephaly (HP:0000252): Head circumference below 2 standard deviations below the mean for age and gender. Evidence: PCS. Frequency: 1/1. (PMID:32385911)
- Status epilepticus (HP:0002133): Status epilepticus is a type of prolonged seizure resulting either from the failure of the mechanisms responsible for seizure termination or from the initiation of mechanisms which lead to abnormally prolonged seizures (after time point t1). It is a condition that can have long-term consequences (after time point t2), including neuronal death, neuronal injury, and alteration of neuronal networks, depending on the type and duration of seizures. Evidence: PCS. Frequency: 1/2. (PMID:33153867)
- Delayed speech and language development (HP:0000750): A degree of language development that is significantly below the norm for a child of a specified age. Evidence: PCS. Frequency: 2/2. (PMID:33153867)
- Bradycardia (HP:0001662): A slower than normal heart rate (in adults, slower than 60 beats per minute). Evidence: PCS. Frequency: 1/2. (PMID:33153867)
- Respiratory distress (HP:0002098): Respiratory distress is objectively observable as the physical or emotional consequences from the experience of dyspnea. The physical presentation of respiratory distress is generally referred to as labored breathing, while the sensation of respiratory distress is called shortness of breath or dyspnea. Evidence: PCS. Frequency: 1/2. (PMID:33153867)
- Increased circulating lactate concentration (HP:0002151): Abnormally increased level of blood lactate (2-hydroxypropanoic acid). Lactate is produced from pyruvate by lactate dehydrogenase during normal metabolism. The terms lactate and lactic acid are often used interchangeably but lactate (the component measured in blood) is strictly a weak base whereas lactic acid is the corresponding acid. Lactic acidosis is often used clinically to describe elevated lactate but should be reserved for cases where there is a corresponding acidosis (pH below 7.35). Evidence: PCS. Frequency: 1/1. (PMID:32385911)
- Increased CSF lactate (HP:0002490): Increased concentration of lactate in the cerebrospinal fluid. Evidence: PCS. Frequency: 1/1. (PMID:32385911)
- Pulmonary arterial hypertension (HP:0002092): Pulmonary hypertension is defined mean pulmonary artery pressure of 25mmHg or more and pulmonary capillary wedge pressure of 15mmHg or less when measured by right heart catheterisation at rest and in a supine position. Evidence: PCS. Frequency: 2/2. (PMID:33153867)
- Severe global developmental delay (HP:0011344): A severe delay in the achievement of motor or mental milestones in the domains of development of a child. Evidence: PCS. Frequency: 1/1. (PMID:32385911)
- Decreased activity of mitochondrial complex I (HP:0011923): A reduction in the activity of the mitochondrial respiratory chain complex I, which is part of the electron transport chain in mitochondria. Evidence: PCS. Frequency: 1/1. (PMID:32385911)
- Corpus callosum atrophy (HP:0007371): The presence of atrophy (wasting) of the corpus callosum. Evidence: PCS. Frequency: 1/1. Onset: Young adult onset (HP:0011462). (PMID:32385911)
- Autosomal recessive inheritance (HP:0000007): A mode of inheritance that is observed for traits related to a gene encoded on one of the autosomes (i.e., the human chromosomes 1-22) in which a trait manifests in individuals with two pathogenic alleles, either homozygotes (two copies of the same mutant allele) or compound heterozygotes (whereby each copy of a gene has a distinct mutant allele). Evidence: PCS. (PMID:32385911)
- Growth delay (HP:0001510): A deficiency or slowing down of growth pre- and postnatally. Evidence: PCS. Frequency: 1/1. (PMID:32385911)
- Hypospadias (HP:0000047): Abnormal position of urethral meatus on the ventral penile shaft (underside) characterized by displacement of the urethral meatus from the tip of the glans penis to the ventral surface of the penis, scrotum, or perineum. Evidence: PCS. Frequency: 1/1. (PMID:33153867)
- Tetraplegia (HP:0002445): Paralysis of all four limbs, and trunk of the body below the level of an associated injury to the spinal cord. The etiology of quadriplegia is similar to that of paraplegia except that the lesion is in the cervical spinal cord rather than in the thoracic or lumbar segments of the spinal cord. Evidence: PCS. Frequency: 1/1. (PMID:32385911)
- Stroke-like episode (HP:0002401): No consensus exists on what a stroke-like episode is, but these episodes can be functionally defined as a new neurological deficit, occurring with or without the context of seizures, which last longer than 24 hours. Evidence: PCS. Frequency: 1/2. (PMID:33153867)